Phenotypes associated with the disease Intellectual disability-muscle weakness-short stature-facial dysmorphism syndrome (ORPHA:457365):
- Narrow mouth (HP:0000160): Distance between the commissures of the mouth more than 2 SD below the mean. Alternatively, an apparently decreased width of the oral aperture (subjective). Evidence: TAS. Frequency: Frequent (HP:0040282). (ORPHA:457365)
- Narrow palate (HP:0000189): Width of the palate more than 2 SD below the mean (objective) or apparently decreased palatal width (subjective). Evidence: TAS. Frequency: Frequent (HP:0040282). (ORPHA:457365)
- Prominent nasal bridge (HP:0000426): Anterior positioning of the nasal root in comparison to the usual positioning for age. Evidence: TAS. Frequency: Frequent (HP:0040282). (ORPHA:457365)
- Deeply set eye (HP:0000490): An eye that is more deeply recessed into the plane of the face than is typical. Evidence: TAS. Frequency: Frequent (HP:0040282). (ORPHA:457365)
- Downslanted palpebral fissures (HP:0000494): The palpebral fissure inclination is more than two standard deviations below the mean. Evidence: TAS. Frequency: Frequent (HP:0040282). (ORPHA:457365)
- Carious teeth (HP:0000670): Caries is a multifactorial bacterial infection affecting the structure of the tooth. This term has been used to describe the presence of more than expected dental caries. Evidence: TAS. Frequency: Frequent (HP:0040282). (ORPHA:457365)
- Delayed speech and language development (HP:0000750): A degree of language development that is significantly below the norm for a child of a specified age. Evidence: TAS. Frequency: Frequent (HP:0040282). (ORPHA:457365)
- Intellectual disability (HP:0001249): The term intellectual disability or intellectual developmental disorder is used to describe significantly sub-average intellectual and adaptive functioning based on clinical assessment and as measured by individually administered, appropriately normed, standardized and validated tests of intellectual functioning and adaptive behavior, with onset during the developmental period from infancy through adolescence. Evidence: TAS. Frequency: Frequent (HP:0040282). (ORPHA:457365)
- Muscle weakness (HP:0001324): Reduced strength of muscles. Evidence: TAS. Frequency: Frequent (HP:0040282). (ORPHA:457365)
- Specific learning disability (HP:0001328): Impairment of certain skills such as reading or writing, coordination, self-control, or attention that interfere with the ability to learn. The impairment is not related to a global deficiency of intelligence. Evidence: TAS. Frequency: Frequent (HP:0040282). (ORPHA:457365)
- Pes planus (HP:0001763): A foot where the longitudinal arch of the foot is in contact with the ground or floor when the individual is standing; or, in a patient lying supine, a foot where the arch is in contact with the surface of a flat board pressed against the sole of the foot by the examiner with a pressure similar to that expected from weight bearing; or, the height of the arch is reduced. Evidence: TAS. Frequency: Frequent (HP:0040282). (ORPHA:457365)
- Overlapping toe (HP:0001845): Describes a foot digit resting on the dorsal surface of an adjacent digit when the foot is at rest. Initially clawing may be dynamic and only noticeable on walking. Over time the plantar plate tears, subluxation occurs at the metatarsophalangeal joint (MTPJ), and the deformity becomes permanent. Evidence: TAS. Frequency: Frequent (HP:0040282). (ORPHA:457365)
- Leukoencephalopathy (HP:0002352): This term describes abnormality of the white matter of the cerebrum resulting from damage to the myelin sheaths of nerve cells. Evidence: TAS. Frequency: Frequent (HP:0040282). (ORPHA:457365)
- Highly arched eyebrow (HP:0002553): Increased height of the central portion of the eyebrow, forming a crescent, semicircular, or inverted U shape. Evidence: TAS. Frequency: Frequent (HP:0040282). (ORPHA:457365)
- Delayed skeletal maturation (HP:0002750): A decreased rate of skeletal maturation. Delayed skeletal maturation can be diagnosed on the basis of an estimation of the bone age from radiographs of specific bones in the human body. Evidence: TAS. Frequency: Frequent (HP:0040282). (ORPHA:457365)
- EMG: myopathic abnormalities (HP:0003458): The presence of abnormal electromyographic patterns indicative of myopathy, such as small-short polyphasic motor unit potentials. Evidence: TAS. Frequency: Frequent (HP:0040282). (ORPHA:457365)
- Short stature (HP:0004322): A height below that which is expected according to age and gender norms. Although there is no universally accepted definition of short stature, many refer to "short stature" as height more than 2 standard deviations below the mean for age and gender (or below the 3rd percentile for age and gender dependent norms). Evidence: TAS. Frequency: Frequent (HP:0040282). (ORPHA:457365)
- Broad columella (HP:0010761): Increased width of the columella. Evidence: TAS. Frequency: Frequent (HP:0040282). (ORPHA:457365)
- Thick lower lip vermilion (HP:0000179): Increased thickness of the lower lip, leading to a prominent appearance of the lower lip. The height of the vermilion of the lower lip in the midline is more than 2 SD above the mean. Alternatively, an apparently increased height of the vermilion of the lower lip in the frontal view (subjective). Evidence: TAS. Frequency: Occasional (HP:0040283). (ORPHA:457365)
- Short chin (HP:0000331): Decreased vertical distance from the vermilion border of the lower lip to the inferior-most point of the chin. Evidence: TAS. Frequency: Occasional (HP:0040283). (ORPHA:457365)
- Ptosis (HP:0000508): The upper eyelid margin is positioned 3 mm or more lower than usual and covers the superior portion of the iris (objective); or, the upper lid margin obscures at least part of the pupil (subjective). Evidence: TAS. Frequency: Occasional (HP:0040283). (ORPHA:457365)
- Blue sclerae (HP:0000592): An abnormal bluish coloration of the sclera. Evidence: TAS. Frequency: Occasional (HP:0040283). (ORPHA:457365)
- Ophthalmoplegia (HP:0000602): Paralysis of one or more extraocular muscles that are responsible for eye movements. Evidence: TAS. Frequency: Occasional (HP:0040283). (ORPHA:457365)
- Tremor (HP:0001337): An unintentional, oscillating to-and-fro muscle movement about a joint axis. Evidence: TAS. Frequency: Occasional (HP:0040283). (ORPHA:457365)